Phenotypes associated with the disease Greenberg dysplasia (ORPHA:1426):
- Micrognathia (HP:0000347): Developmental hypoplasia of the mandible. Evidence: TAS. Frequency: Frequent (HP:0040282). (ORPHA:1426)
- Narrow chest (HP:0000774): Reduced width of the chest from side to side, associated with a reduced distance from the sternal notch to the tip of the shoulder. Evidence: TAS. Frequency: Frequent (HP:0040282). (ORPHA:1426)
- Platyspondyly (HP:0000926): A flattened vertebral body shape with reduced distance between the vertebral endplates. Evidence: TAS. Frequency: Very frequent (HP:0040281). (ORPHA:1426)
- Lymphedema (HP:0001004): Localized fluid retention and tissue swelling caused by a compromised lymphatic system. Evidence: TAS. Frequency: Very frequent (HP:0040281). (ORPHA:1426)
- Brachydactyly (HP:0001156): Digits that appear disproportionately short compared to the hand/foot. The word brachydactyly is used here to describe a series distinct patterns of shortened digits (brachydactyly types A-E). This is the sense used here. Evidence: TAS. Frequency: Very frequent (HP:0040281). (ORPHA:1426)
- Calvarial skull defect (HP:0001362): A localized defect in the bone of the skull resulting from abnormal embryological development. The defect is covered by normal skin. In some cases, skull x-rays have shown underlying lytic bone lesions which have closed before the age of one year. Evidence: TAS. Frequency: Frequent (HP:0040282). (ORPHA:1426)
- Abnormal leukocyte morphology (HP:0001881): An abnormality of leukocytes. Evidence: TAS. Frequency: Very frequent (HP:0040281). (ORPHA:1426)
- Micromelia (HP:0002983): The presence of abnormally small extremities. Evidence: TAS. Frequency: Very frequent (HP:0040281). (ORPHA:1426)
- Abnormal vertebral body morphology (HP:0003312): Abnormal form of vertebral body, which is the central cylindrical portion of the vertebra that together with other structures such as the vertebral arch, pedicles, laminae, spinous process, transverse processes, and articular facets makes up a vertebra. Evidence: TAS. Frequency: Very frequent (HP:0040281). (ORPHA:1426)
- Decreased skull ossification (HP:0004331): A reduction in the magnitude or amount of ossification of the skull. Evidence: TAS. Frequency: Frequent (HP:0040282). (ORPHA:1426)
- Anterior rib punctate calcifications (HP:0006619): Deposition of calcium salts in point-like foci within the anterior portion of one or more ribs. Evidence: TAS. Frequency: Very frequent (HP:0040281). (ORPHA:1426)
- Severe short-limb dwarfism (HP:0008890). Evidence: TAS. Frequency: Very frequent (HP:0040281). (ORPHA:1426)
- Rhizomelia (HP:0008905): Disproportionate shortening of the proximal segment of limbs (i.e. the femur and humerus). Evidence: TAS. Frequency: Very frequent (HP:0040281). (ORPHA:1426)
- Abnormal pelvis bone ossification (HP:0009106): An abnormality of the formation and mineralization of any bone of the bony pelvis. Evidence: TAS. Frequency: Very frequent (HP:0040281). (ORPHA:1426)
- Midface retrusion (HP:0011800): Posterior positions and/or vertical shortening of the infraorbital and perialar regions, or increased concavity of the face and/or reduced nasolabial angle. Evidence: TAS. Frequency: Frequent (HP:0040282). (ORPHA:1426)
- Abnormal bone ossification (HP:0011849): Any anomaly in the formation of bone or of a bony substance, or the conversion of fibrous tissue or of cartilage into bone or a bony substance. Evidence: TAS. Frequency: Very frequent (HP:0040281). (ORPHA:1426)
- Abnormally ossified vertebrae (HP:0100569): An abnormality of the formation and mineralization of one or more vertebrae. Evidence: TAS. Frequency: Very frequent (HP:0040281). (ORPHA:1426)
- Preeclampsia (HP:0100602): Pregnancy-induced hypertension in association with significant amounts of protein in the urine. Evidence: TAS. Frequency: Frequent (HP:0040282). (ORPHA:1426)